- Elevated erythrocyte sedimentation rate (HP:0003565): An increased erythrocyte sedimentation rate (ESR). The ESR is a test that measures the distance that erythrocytes have fallen after one hour in a vertical column of anticoagulated blood under the influence of gravity. The ESR is a nonspecific finding. An elevation may indicate inflammation or may be caused by any condition that elevates fibrinogen. Evidence: TAS. Frequency: Very frequent (HP:0040281). (ORPHA:93552)
- Decreased circulating complement C3 concentration (HP:0005421): Concentration of the complement component C3 in the blood circulation below the lower limit of normal. Evidence: TAS. Frequency: Very frequent (HP:0040281). (ORPHA:93552)
- Decreased circulating complement C4 concentration (HP:0045042): Concentration of the complement component C4 in the blood circulation below the lower limit of normal. Evidence: TAS. Frequency: Very frequent (HP:0040281). (ORPHA:93552)
- Abnormality of the urinary system (HP:0000079): An abnormality of the urinary system. Evidence: TAS. Frequency: Frequent (HP:0040282). (ORPHA:93552)
- Renal insufficiency (HP:0000083): A reduction in the level of performance of the kidneys in areas of function comprising the concentration of urine, removal of wastes, the maintenance of electrolyte balance, homeostasis of blood pressure, and calcium metabolism. Evidence: TAS. Frequency: Frequent (HP:0040282). (ORPHA:93552)
- Proteinuria (HP:0000093): Increased levels of protein in the urine. Evidence: TAS. Frequency: Frequent (HP:0040282). (ORPHA:93552)
- Nephrotic syndrome (HP:0000100): Nephrotic syndrome is a collection of findings resulting from glomerular dysfunction with an increase in glomerular capillary wall permeability associated with pronounced proteinuria. Nephrotic syndrome refers to the constellation of clinical findings that result from severe renal loss of protein, with Proteinuria and hypoalbuminemia, edema, and hyperlipidemia. Evidence: TAS. Frequency: Frequent (HP:0040282). (ORPHA:93552)
- Nephritis (HP:0000123): The presence of inflammation affecting the kidney. Evidence: TAS. Frequency: Frequent (HP:0040282). (ORPHA:93552)
- Hematuria (HP:0000790): The presence of blood in the urine. Hematuria may be gross hematuria (visible to the naked eye) or microscopic hematuria (detected by dipstick or microscopic examination of the urine). Evidence: TAS. Frequency: Frequent (HP:0040282). (ORPHA:93552)
- Abnormality of the skin (HP:0000951): An abnormality of the skin. Evidence: TAS. Frequency: Frequent (HP:0040282). (ORPHA:93552)
- Edema (HP:0000969): An abnormal accumulation of fluid beneath the skin, or in one or more cavities of the body. Evidence: TAS. Frequency: Frequent (HP:0040282). (ORPHA:93552)
- Skin rash (HP:0000988): A red eruption of the skin. Evidence: TAS. Frequency: Frequent (HP:0040282). (ORPHA:93552)
- Pericardial effusion (HP:0001698): Accumulation of fluid within the pericardium. Evidence: TAS. Frequency: Frequent (HP:0040282). (ORPHA:93552)
- Thrombocytopenia (HP:0001873): A reduction in the number of circulating thrombocytes. Evidence: TAS. Frequency: Frequent (HP:0040282). (ORPHA:93552)
- Decreased total leukocyte count (HP:0001882): An abnormal decreased number of leukocytes in the blood. Evidence: TAS. Frequency: Frequent (HP:0040282). (ORPHA:93552)
- Decreased total lymphocyte count (HP:0001888): A reduced number of lymphocytes in the blood. Evidence: TAS. Frequency: Frequent (HP:0040282). (ORPHA:93552)
- Microangiopathic hemolytic anemia (HP:0001937). Evidence: TAS. Frequency: Frequent (HP:0040282). (ORPHA:93552)
- Fever (HP:0001945): Body temperature elevated above the normal range. Evidence: TAS. Frequency: Frequent (HP:0040282). (ORPHA:93552)
- Pleural effusion (HP:0002202): The presence of an excessive amount of fluid in the pleural cavity. Evidence: TAS. Frequency: Frequent (HP:0040282). (ORPHA:93552)
- Lymphadenopathy (HP:0002716): Enlargement (swelling) of a lymph node. Evidence: TAS. Frequency: Frequent (HP:0040282). (ORPHA:93552)
- Antinuclear antibody positivity (HP:0003493): The presence of autoantibodies in the serum that react against nuclei or nuclear components. Evidence: TAS. Frequency: Frequent (HP:0040282). (ORPHA:93552)
- Antiphospholipid antibody positivity (HP:0003613): The presence of circulating autoantibodies to phospholipids. Evidence: TAS. Frequency: Frequent (HP:0040282). (ORPHA:93552)
- Abnormality of the gastrointestinal tract (HP:0011024): An abnormality of the gastrointestinal tract. Evidence: TAS. Frequency: Frequent (HP:0040282). (ORPHA:93552)
- Increased circulating lactate dehydrogenase concentration (HP:0025435): An elevated level of the enzyme lactate dehydrogenase in the blood circulation. Evidence: TAS. Frequency: Frequent (HP:0040282). (ORPHA:93552)
- Oral ulcer (HP:0000155): Erosion of the mucous mebrane of the mouth with local excavation of the surface, resulting from the sloughing of inflammatory necrotic tissue. Evidence: TAS. Frequency: Occasional (HP:0040283). (ORPHA:93552)
- Abnormality of the nervous system (HP:0000707): An abnormality of the nervous system. Evidence: TAS. Frequency: Occasional (HP:0040283). (ORPHA:93552)
- Psychosis (HP:0000709): A condition characterized by changes in personality and thought patterns, often accompanied by hallucinations and delusional beliefs, is known as psychosis. Evidence: TAS. Frequency: Occasional (HP:0040283). (ORPHA:93552)
- Seizure (HP:0001250): A seizure is an intermittent abnormality of nervous system physiology characterized by a transient occurrence of signs and/or symptoms due to abnormal excessive or synchronous neuronal activity in the brain. Evidence: TAS. Frequency: Occasional (HP:0040283). (ORPHA:93552)
- Muscle weakness (HP:0001324): Reduced strength of muscles. Evidence: TAS. Frequency: Occasional (HP:0040283). (ORPHA:93552)
- Arthritis (HP:0001369): Inflammation of a joint. Evidence: TAS. Frequency: Occasional (HP:0040283). (ORPHA:93552)
- Ascites (HP:0001541): Accumulation of fluid in the peritoneal cavity (between the layers of the peritoneum that lines the abdomen). Evidence: TAS. Frequency: Occasional (HP:0040283). (ORPHA:93552)
- Vomiting (HP:0002013): Forceful ejection of the contents of the stomach through the mouth by means of a series of involuntary spasmic contractions. Evidence: TAS. Frequency: Occasional (HP:0040283). (ORPHA:93552)
- Abdominal pain (HP:0002027): An unpleasant sensation characterized by physical discomfort (such as pricking, throbbing, or aching) and perceived to originate in the abdomen. Evidence: TAS. Frequency: Occasional (HP:0040283). (ORPHA:93552)
- Abnormality of the respiratory system (HP:0002086): An abnormality of the respiratory system, which include the airways, lungs, and the respiratory muscles. Evidence: TAS. Frequency: Occasional (HP:0040283). (ORPHA:93552)
- Dyspnea (HP:0002094): Difficult or labored breathing. Dyspnea is a subjective feeling only the patient can rate, e.g., on a Borg scale. Evidence: TAS. Frequency: Occasional (HP:0040283). (ORPHA:93552)
- Hemiplegia (HP:0002301): Paralysis (complete loss of muscle function) in the arm, leg, and in some cases the face on one side of the body. Evidence: TAS. Frequency: Occasional (HP:0040283). (ORPHA:93552)
- Headache (HP:0002315): Cephalgia, or pain sensed in various parts of the head, not confined to the area of distribution of any nerve. Evidence: TAS. Frequency: Occasional (HP:0040283). (ORPHA:93552)
- Systemic lupus erythematosus (HP:0002725): A chronic, relapsing, inflammatory, and often febrile multisystemic disorder of connective tissue, characterized principally by involvement of the skin, joints, kidneys, and serosal membranes. Evidence: TAS. Frequency: Occasional (HP:0040283). (ORPHA:93552)
- Arthralgia (HP:0002829): Joint pain. Evidence: TAS. Frequency: Occasional (HP:0040283). (ORPHA:93552)
- Abdominal distention (HP:0003270): Distention of the abdomen. Evidence: TAS. Frequency: Occasional (HP:0040283). (ORPHA:93552)
- Reduced consciousness (HP:0004372): Abnormally diminished level of attention, responsiveness, or wakefulness. Evidence: TAS. Frequency: Occasional (HP:0040283). (ORPHA:93552)
- Discoid lupus rash (HP:0007417): Cutaneous lesion that develops as a dry, scaly, red patch that evolves to an indurated and hyperpigmented plaque with adherent scale. Scarring may result in central white patches (loss of pigmentation) and skin atrophy. Evidence: TAS. Frequency: Occasional (HP:0040283). (ORPHA:93552)
- Malar rash (HP:0025300): An erythematous (red), flat facial rash that affects the skin in the malar area (over the cheekbones) and extends over the bridge of the nose. Evidence: TAS. Frequency: Occasional (HP:0040283). (ORPHA:93552)
- Lupus anticoagulant (HP:0025343): Presence of lupus anticoagulant (LA) autoantibodies. LA represent a heterogeneous group of autoantibodies, IgG, IgM, or a mixture of both classes, that interfere with standard phospholipid-based coagulant tests (this is only an in vitro phenomenon, LA do not cause reduction of coagulation in vivo). The antibodies are directed against plasma proteins which also bind to phospholipid surfaces. Evidence: TAS. Frequency: Occasional (HP:0040283). (ORPHA:93552)
- Dark urine (HP:0040319): An abnormal dark color of the urine. Evidence: TAS. Frequency: Occasional (HP:0040283). (ORPHA:93552)
- Alopecia (HP:0001596): A noncongenital process of hair loss, which may progress to partial or complete baldness. Evidence: TAS. Frequency: Very rare (HP:0040284). (ORPHA:93552)
- Diarrhea (HP:0002014): Abnormally increased frequency (usually defined as three or more) loose or watery bowel movements a day. Evidence: TAS. Frequency: Very rare (HP:0040284). (ORPHA:93552)
- Language impairment (HP:0002463): Language impairment is a deficit in comprehension or production of language that includes reduced vocabulary, limited sentence structure, or impairments in written or spoken communication. Language abilities are substantially and quantifiably below age expectations. Evidence: TAS. Frequency: Very rare (HP:0040284). (ORPHA:93552)
- Antineutrophil antibody positivity (HP:0003453): The presence of autoantibodies in the serum that react against neutrophils. Evidence: TAS. Frequency: Very rare (HP:0040284). (ORPHA:93552)
- Raynaud phenomenon (HP:0030880). Evidence: TAS. Frequency: Very rare (HP:0040284). (ORPHA:93552)
- Cognitive impairment (HP:0100543): Abnormal cognition is characterized by deficits in thinking, reasoning, or remembering. Evidence: TAS. Frequency: Very rare (HP:0040284). (ORPHA:93552)
- Myositis (HP:0100614): A general term for inflammation of the muscles without respect to the underlying cause. Evidence: TAS. Frequency: Very rare (HP:0040284). (ORPHA:93552)
- Chest pain (HP:0100749): An unpleasant sensation characterized by physical discomfort (such as pricking, throbbing, or aching) localized to the chest. Evidence: TAS. Frequency: Very rare (HP:0040284). (ORPHA:93552)
These phenotypes are associated with the disease Pediatric systemic lupus erythematosus (ORPHA:93552).